Phenotypes associated with the disease lateral meningocele syndrome (OMIM:130720):
- Tethered cord (HP:0002144): During normal embryological development, the spinal cord first occupies the entire length of the vertebral column but goes on to assume a position at the level of L1 due to differential growth of the conus medullaris and the vertebral column. The filum terminale is a slender, threadlike structure that remains after the normal regression of the distal embryonic spinal cord and attaches the spinal cord to the coccyx. A tethered cord results if there is a thickened rope-like filum terminale which anchors the cord at the level of L2 or below, potentially causing neurologic signs owing to abnormal tension on the spinal cord. Evidence: PCS. Frequency: 1/6. (PMID:25394726)
- Short stature (HP:0004322): A height below that which is expected according to age and gender norms. Although there is no universally accepted definition of short stature, many refer to "short stature" as height more than 2 standard deviations below the mean for age and gender (or below the 3rd percentile for age and gender dependent norms). Evidence: PCS. Frequency: 2/6. (PMID:25394726)
- Syringomyelia (HP:0003396): Dilated, glial-lined cavity in spinal cord. This cavity does not communicate with the central canal, and usually is between the dorsal columns unilaterally or bilaterally along the side of the cord. Evidence: PCS. Frequency: 3/6. (PMID:25394726)
- Decreased muscle mass (HP:0003199). Evidence: PCS. Frequency: 3/4. (PMID:25394726)
- Hypotonia (HP:0001252): Hypotonia is an abnormally low muscle tone (the amount of tension or resistance to movement in a muscle). Even when relaxed, muscles have a continuous and passive partial contraction which provides some resistance to passive stretching. Hypotonia thus manifests as diminished resistance to passive stretching. Hypotonia is not the same as muscle weakness, although the two conditions can co-exist. Evidence: PCS. Frequency: 6/6. (PMID:25394726)
- Short nasal bridge (HP:0003194): Decreased superior-inferior length of the nasal bridge, which is the saddle-shaped area that includes the nasal root and the lateral aspects of the nose. Evidence: IEA. (OMIM:130720)
- Smooth philtrum (HP:0000319): Flat skin surface, with no ridge formation in the central region of the upper lip between the nasal base and upper vermilion border. Evidence: TAS. (OMIM:130720)
- Bicuspid aortic valve (HP:0001647): The presence of an aortic valve with two instead of the normal three cusps (flaps). Bicuspid aortic valvue is a malformation of a commissure (small space between the attachment of each cusp to the aortic wall) and the adjacent parts of the two corresponding cusps forming a raphe (the fused area of the two underdeveloped cusps turning into a malformed commissure between both cusps; the raphe is a fibrous ridge that extends from the commissure to the free edge of the two underdeveloped, conjoint cusps). Evidence: PCS. Frequency: 1/6. (PMID:25394726)
- Hypertelorism (HP:0000316): Interpupillary distance more than 2 SD above the mean (alternatively, the appearance of an increased interpupillary distance or widely spaced eyes). Evidence: PCS. Frequency: 4/6. (PMID:25394726)
- Dental crowding (HP:0000678): Changes in alignment of teeth in the dental arch. Evidence: IEA. (OMIM:130720)
- Hydrocephalus (HP:0000238): Hydrocephalus is an active distension of the ventricular system of the brain resulting from inadequate passage of CSF from its point of production within the cerebral ventricles to its point of absorption into the systemic circulation. Evidence: PCS. Frequency: 1/6. (PMID:25394726)
- Patent ductus arteriosus (HP:0001643): In utero, the ductus arteriosus (DA) serves to divert ventricular output away from the lungs and toward the placenta by connecting the main pulmonary artery to the descending aorta. A patent ductus arteriosus (PDA) in the first 3 days of life is a physiologic shunt in healthy term and preterm newborn infants, and normally is substantially closed within about 24 hours after bith and completely closed after about three weeks. Failure of physiologcal closure is referred to a persistent or patent ductus arteriosus (PDA). Depending on the degree of left-to-right shunting, PDA can have clinical consequences. Evidence: PCS. Frequency: 2/6. (PMID:25394726)
- Posteriorly rotated ears (HP:0000358): A type of abnormal location of the ears in which the position of the ears is characterized by posterior rotation (the superior part of the ears is rotated towards the back of the head, and the inferior part of the ears towards the front). Evidence: IEA. (OMIM:130720)
- Intellectual disability (HP:0001249): The term intellectual disability or intellectual developmental disorder is used to describe significantly sub-average intellectual and adaptive functioning based on clinical assessment and as measured by individually administered, appropriately normed, standardized and validated tests of intellectual functioning and adaptive behavior, with onset during the developmental period from infancy through adolescence. Evidence: PCS. Frequency: 1/5. (PMID:25394726)
- Neurogenic bladder (HP:0000011): A type of bladder dysfunction caused by neurologic damage. Neurogenic bladder can be flaccid or spastic. Common manifestatios of neurogenic bladder are overflow incontinence, frequency, urgency, urge incontinence, and retention. Evidence: PCS. Frequency: 1/6. (PMID:25394726)
- Downslanted palpebral fissures (HP:0000494): The palpebral fissure inclination is more than two standard deviations below the mean. Evidence: PCS. Frequency: 5/6. (PMID:25394726)
- Cleft palate (HP:0000175): Cleft palate is a developmental defect of the palate resulting from a failure of fusion of the palatine processes and manifesting as a separation of the roof of the mouth (soft and hard palate). Evidence: PCS. Frequency: 1/6. (PMID:25394726)
- Obstructive sleep apnea (HP:0002870): Obstructive Sleep Apnea is a condition characterized by the obstruction of the airway and pauses in breathing during sleep, which occur multiple times throughout the night. It is related to the relaxation of muscle tone that typically happens during sleep, leading to a partial collapse of the soft tissues in the airway and causing airflow obstruction. Evidence: PCS. Frequency: 3/4. (PMID:25394726)
- Joint hypermobility (HP:0001382): The capability that a joint (or a group of joints) has to move, passively and/or actively, beyond normal limits along physiological axes. Evidence: PCS. Frequency: 6/6. (PMID:25394726)
- Abnormality of the middle ear ossicles (HP:0004452): An abnormality of the middle-ear ossicles (three small bones called malleus, incus, and stapes) that are contained within the middle ear and serve to transmit sounds from the air to the fluid-filled labyrinth (cochlea). Evidence: IEA. (OMIM:130720)
- Global developmental delay (HP:0001263): A delay in the achievement of motor or mental milestones in the domains of development of a child, including motor skills, speech and language, cognitive skills, and social and emotional skills. This term should only be used to describe children younger than five years of age. Evidence: PCS. Frequency: 6/6. (PMID:25394726)
- Dural ectasia (HP:0100775): A widening or ballooning of the dural sac surrounding the spinal cord usually at the lumbosacral level. Evidence: TAS. (OMIM:130720)
- Keloids (HP:0010562). Evidence: PCS. Frequency: 4/6. (PMID:25394726)
- Vertebral fusion (HP:0002948): A developmental defect leading to the union of two adjacent vertebrae. Evidence: PCS. Frequency: 2/6. (PMID:25394726)
- Pectus excavatum (HP:0000767): A defect of the chest wall characterized by a depression of the sternum, giving the chest ("pectus") a caved-in ("excavatum") appearance. Evidence: PCS. Frequency: 2/5. (PMID:25394726)
- Umbilical hernia (HP:0001537): Protrusion of abdominal contents through a defect in the abdominal wall musculature around the umbilicus. Skin and subcutaneous tissue overlie the defect. Evidence: PCS. Frequency: 1/6. (PMID:25394726)
- Conductive hearing impairment (HP:0000405): An abnormality of vibrational conductance of sound to the inner ear leading to impairment of sensory perception of sound. Evidence: IEA. (OMIM:130720)
- Autosomal dominant inheritance (HP:0000006): A mode of inheritance that is observed for traits related to a gene encoded on one of the autosomes (i.e., the human chromosomes 1-22) in which a trait manifests in heterozygotes. In the context of medical genetics, an autosomal dominant disorder is caused when a single copy of the mutant allele is present. Males and females are affected equally, and can both transmit the disorder with a risk of 50% for each child of inheriting the mutant allele. Evidence: PCS. (PMID:25394726)
- Low-set ears (HP:0000369): Upper insertion of the ear to the scalp below an imaginary horizontal line drawn between the inner canthi of the eye and extending posteriorly to the ear. Evidence: PCS. Frequency: 6/6. (PMID:25394726)
- Hypernasal speech (HP:0001611): A type of speech characterized by the presence of an abnormally increased nasal airflow during speech associated with structural abnormality of the nasal passages. Evidence: PCS. Frequency: 4/4. (PMID:25394726)
- Congenital onset (HP:0003577): A phenotypic abnormality that is present at birth. Evidence: PCS. Frequency: 6/6. (PMID:25394726)
- Long philtrum (HP:0000343): Distance between nasal base and midline upper lip vermilion border more than 2 SD above the mean. Alternatively, an apparently increased distance between nasal base and midline upper lip vermilion border. Evidence: TAS. (OMIM:130720)
- Biconcave vertebral bodies (HP:0004586): Exaggerated concavity of the anterior or posterior surface of the vertebral body, i.e., the upper and lower vertebral endplates are hollowed inward. Evidence: IEA. (OMIM:130720)
- Inguinal hernia (HP:0000023): Protrusion of the contents of the abdominal cavity through the inguinal canal. Evidence: PCS. Frequency: 3/5. (PMID:25394726)
- Thickened calvaria (HP:0002684): The presence of an abnormally thick calvaria. Evidence: PCS. Frequency: 2/4. (PMID:25394726)
- Motor delay (HP:0001270): A type of Developmental delay characterized by a delay in acquiring motor skills. Evidence: TAS. (OMIM:130720)
- Ventricular septal defect (HP:0001629): A hole between the two bottom chambers (ventricles) of the heart. The defect is centered around the most superior aspect of the ventricular septum. Evidence: PCS. Frequency: 2/6. (PMID:25394726)
- Arachnoid cyst (HP:0100702): An extra-parenchymal and intra-arachnoidal collection of fluid with a composition similar to that of cerebrospinal fluid. Evidence: TAS. (OMIM:130720)
- High palate (HP:0000218): Height of the palate more than 2 SD above the mean (objective) or palatal height at the level of the first permanent molar more than twice the height of the teeth (subjective). Evidence: PCS. Frequency: 4/5. (PMID:25394726)
- Meningocele (HP:0002435): Protrusion of the meninges through a defect of the skull or vertebral column. Evidence: IEA. (OMIM:130720)
- Sclerosis of skull base (HP:0002694): Increased bone density of the skull base without significant changes in bony contour. Evidence: IEA. (OMIM:130720)
- Scoliosis (HP:0002650): The presence of an abnormal lateral curvature of the spine. Evidence: PCS. Frequency: 5/6. (PMID:25394726)
- Malar flattening (HP:0000272): Underdevelopment of the malar prominence of the jugal bone (zygomatic bone in mammals), appreciated in profile, frontal view, and/or by palpation. Evidence: PCS. Frequency: 6/6. (PMID:25394726)
- Platybasia (HP:0002691): A developmental malformation of the occipital bone and upper end of the cervical spine, in which the latter appears to have pushed the floor of the occipital bone upward such that there is an abnormal flattening of the skull base. Evidence: IEA. (OMIM:130720)
- Short neck (HP:0000470): Diminished length of the neck. Evidence: IEA. (OMIM:130720)
- Kyphosis (HP:0002808): Exaggerated anterior convexity of the thoracic vertebral column. Evidence: IEA. (OMIM:130720)
- Telecanthus (HP:0000506): Distance between the inner canthi more than two standard deviations above the mean (objective); or, apparently increased distance between the inner canthi. Evidence: PCS. Frequency: 2/6. (PMID:25394726)
- Chiari type I malformation (HP:0007099): Arnold-Chiari type I malformation refers to a relatively mild degree of herniation of the posteroinferior region of the cerebellum (the cerebellar tonsils) into the cervical canal with little or no displacement of the fourth ventricle. It is characterized by one or both pointed (not rounded) cerebellar tonsils that project 5 mm below the foramen magnum, measured by a line drawn from the basion to the opisthion (McRae Line). Evidence: PCS. Frequency: 1/6. (PMID:25394726)
- Ptosis (HP:0000508): The upper eyelid margin is positioned 3 mm or more lower than usual and covers the superior portion of the iris (objective); or, the upper lid margin obscures at least part of the pupil (subjective). Evidence: PCS. Frequency: 6/6. (PMID:25394726)
- Coarse hair (HP:0002208): Hair shafts are rough in texture. Evidence: PCS. Frequency: 6/6. (PMID:25394726)
- Dolichocephaly (HP:0000268): An abnormality of skull shape characterized by a increased anterior-posterior diameter, i.e., an increased antero-posterior dimension of the skull. Cephalic index less than 76%. Alternatively, an apparently increased antero-posterior length of the head compared to width. Often due to premature closure of the sagittal suture. Evidence: TAS. (OMIM:130720)
- Wormian bones (HP:0002645): The presence of extra bones within a cranial suture. Wormian bones are irregular isolated bones which appear in addition to the usual centers of ossification of the cranium. Evidence: PCS. Frequency: 2/4. (PMID:25394726)
- Cryptorchidism (HP:0000028): Testis in inguinal canal. That is, absence of one or both testes from the scrotum owing to failure of the testis or testes to descend through the inguinal canal to the scrotum. Evidence: PCS. Frequency: 4/6. (PMID:25394726)
- Micrognathia (HP:0000347): Developmental hypoplasia of the mandible. Evidence: PCS. Frequency: 6/6. (PMID:25394726)
- Aortic aneurysm (HP:0004942): Aortic dilatation refers to a dimension that is greater than the 95th percentile for the normal person age, sex and body size. In contrast, an aneurysm is defined as a localized dilation of the aorta that is more than 150 percent of predicted (ratio of observed to expected diameter 1.5 or more). Aneurysm should be distinguished from ectasia, which represents a diffuse dilation of the aorta less than 50 percent of normal aorta diameter. Evidence: PCS. Frequency: 2/6. (PMID:25394726)